Phenotypes associated with the disease BRESEK syndrome (ORPHA:85284):
- Cryptorchidism (HP:0000028): Testis in inguinal canal. That is, absence of one or both testes from the scrotum owing to failure of the testis or testes to descend through the inguinal canal to the scrotum. Evidence: TAS. Frequency: Very frequent (HP:0040281). (ORPHA:85284)
- Vesicoureteral reflux (HP:0000076): Abnormal (retrograde) movement of urine from the bladder into ureters or kidneys related to inadequacy of the valvular mechanism at the ureterovesicular junction or other causes. Evidence: TAS. Frequency: Frequent (HP:0040282). (ORPHA:85284)
- Renal hypoplasia (HP:0000089): Hypoplasia of the kidney. Evidence: TAS. Frequency: Very frequent (HP:0040281). (ORPHA:85284)
- Renal dysplasia (HP:0000110): The presence of developmental dysplasia of the kidney. Evidence: TAS. Frequency: Frequent (HP:0040282). (ORPHA:85284)
- Cleft palate (HP:0000175): Cleft palate is a developmental defect of the palate resulting from a failure of fusion of the palatine processes and manifesting as a separation of the roof of the mouth (soft and hard palate). Evidence: TAS. Frequency: Frequent (HP:0040282). (ORPHA:85284)
- Hydrocephalus (HP:0000238): Hydrocephalus is an active distension of the ventricular system of the brain resulting from inadequate passage of CSF from its point of production within the cerebral ventricles to its point of absorption into the systemic circulation. Evidence: TAS. Frequency: Very frequent (HP:0040281). (ORPHA:85284)
- Microcephaly (HP:0000252): Head circumference below 2 standard deviations below the mean for age and gender. Evidence: TAS. Frequency: Very frequent (HP:0040281). (ORPHA:85284)
- Hearing impairment (HP:0000365): A decreased magnitude of the sensory perception of sound. Evidence: TAS. Frequency: Frequent (HP:0040282). (ORPHA:85284)
- Low-set ears (HP:0000369): Upper insertion of the ear to the scalp below an imaginary horizontal line drawn between the inner canthi of the eye and extending posteriorly to the ear. Evidence: TAS. Frequency: Very frequent (HP:0040281). (ORPHA:85284)
- Protruding ear (HP:0000411): Angle formed by the plane of the ear and the mastoid bone greater than the 97th centile for age (objective); or, outer edge of the helix more than 2 cm from the mastoid at the point of maximum distance (objective). Evidence: TAS. Frequency: Very frequent (HP:0040281). (ORPHA:85284)
- Convex nasal ridge (HP:0000444): Nasal ridge curving anteriorly to an imaginary line that connects the nasal root and tip. The nose appears often also prominent, and the columella low. Evidence: TAS. Frequency: Frequent (HP:0040282). (ORPHA:85284)
- Microphthalmia (HP:0000568): A developmental anomaly characterized by abnormal smallness of one or both eyes. Evidence: TAS. Frequency: Frequent (HP:0040282). (ORPHA:85284)
- Optic nerve hypoplasia (HP:0000609): Underdevelopment of the optic nerve. Evidence: TAS. Frequency: Very frequent (HP:0040281). (ORPHA:85284)
- Iris coloboma (HP:0000612): A coloboma of the iris. Evidence: TAS. Frequency: Frequent (HP:0040282). (ORPHA:85284)
- Postaxial hand polydactyly (HP:0001162): Supernumerary digits located at the ulnar side of the hand (that is, on the side with the fifth finger). Evidence: TAS. Frequency: Frequent (HP:0040282). (ORPHA:85284)
- Global developmental delay (HP:0001263): A delay in the achievement of motor or mental milestones in the domains of development of a child, including motor skills, speech and language, cognitive skills, and social and emotional skills. This term should only be used to describe children younger than five years of age. Evidence: TAS. Frequency: Very frequent (HP:0040281). (ORPHA:85284)
- Plagiocephaly (HP:0001357): Asymmetric head shape, which is usually a combination of unilateral occipital flattening with ipsilateral frontal prominence, leading to rhomboid cranial shape. Evidence: TAS. Frequency: Frequent (HP:0040282). (ORPHA:85284)
- Growth delay (HP:0001510): A deficiency or slowing down of growth pre- and postnatally. Evidence: TAS. Frequency: Very frequent (HP:0040281). (ORPHA:85284)
- Intrauterine growth retardation (HP:0001511): An abnormal restriction of fetal growth with fetal weight below the tenth percentile for gestational age. Evidence: TAS. Frequency: Frequent (HP:0040282). (ORPHA:85284)
- Alopecia (HP:0001596): A noncongenital process of hair loss, which may progress to partial or complete baldness. Evidence: TAS. Frequency: Very frequent (HP:0040281). (ORPHA:85284)
- Aganglionic megacolon (HP:0002251): An abnormality resulting from a lack of intestinal ganglion cells (i.e., an aganglionic section of bowel) that results in bowel obstruction with enlargement of the colon. Evidence: TAS. Frequency: Frequent (HP:0040282). (ORPHA:85284)
- Scoliosis (HP:0002650): The presence of an abnormal lateral curvature of the spine. Evidence: TAS. Frequency: Frequent (HP:0040282). (ORPHA:85284)
- Hemivertebrae (HP:0002937): Absence of one half of the vertebral body. Evidence: TAS. Frequency: Frequent (HP:0040282). (ORPHA:85284)
- Neonatal death (HP:0003811): Death within the first 28 days of life. Evidence: TAS. Frequency: Frequent (HP:0040282). (ORPHA:85284)
- Hypoplasia of the bladder (HP:0005343): Underdevelopment of the urinary bladder. Evidence: TAS. Frequency: Very frequent (HP:0040281). (ORPHA:85284)
- Ichthyosis (HP:0008064): An abnormality of the skin characterized the presence of excessive amounts of dry surface scales on the skin resulting from an abnormality of keratinization. Evidence: TAS. Frequency: Occasional (HP:0040283). (ORPHA:85284)
- Decreased testicular size (HP:0008734): Reduced volume of the testicle (the male gonad). Evidence: TAS. Frequency: Frequent (HP:0040282). (ORPHA:85284)
- Severe intellectual disability (HP:0010864): Severe intellectual disability (ID) is defined as a type of ID characterized by severely sub-average adaptive functioning and intellectual functioning, with an intelligence quotient (IQ) the range of 20-34. Evidence: TAS. Frequency: Very frequent (HP:0040281). (ORPHA:85284)
- Abnormal brain morphology (HP:0012443): A structural abnormality of the brain, which has as its parts the forebrain, midbrain, and hindbrain. Evidence: TAS. Frequency: Very frequent (HP:0040281). (ORPHA:85284)